Phenotypes associated with the disease seborrhea-like dermatitis with psoriasiform elements (OMIM:610227):
- Keratosis pilaris (HP:0032152): An anomaly of the hair follicles of the skin that typically presents as small, rough, brown folliculocentric papules distributed over characteristic areas of the skin, particularly the outer-upper arms and thighs. Evidence: PCS. (PMID:16751772)
- Seborrheic dermatitis (HP:0001051): Seborrheic dermatitis is a form of eczema which is closely related to dandruff. It causes dry or greasy peeling of the scalp, eyebrows, and face, and sometimes trunk. Evidence: PCS. (PMID:16751772)
- Epidermal acanthosis (HP:0025092): Diffuse hypertrophy or thickening of the stratum spinosum of the epidermis (prickle cell layer of the skin). Evidence: PCS. (PMID:16751772)
- Autosomal dominant inheritance (HP:0000006): A mode of inheritance that is observed for traits related to a gene encoded on one of the autosomes (i.e., the human chromosomes 1-22) in which a trait manifests in heterozygotes. In the context of medical genetics, an autosomal dominant disorder is caused when a single copy of the mutant allele is present. Males and females are affected equally, and can both transmit the disorder with a risk of 50% for each child of inheriting the mutant allele. Evidence: PCS. (PMID:16751772)
- Hyperkeratosis (HP:0000962): Hyperkeratosis is a histopathological term defining a thickened stratum corneum and may be present in many different skin conditions, with many possible overlaps. Hyperkeratosis refers to the increased thickness of the stratum corneum, the outer layer of the skin. Hyperkeratosis is subclassified as orthokeratotic or parakeratotic. Orthokeratotic hyperkeratosis refers to the thickening of the keratin layer with preserved keratinocyte maturation, while parakeratotic hyperkeratosis shows retained nuclei as a sign of delayed maturation of keratinocytes. Evidence: PCS. (PMID:16751772)